Phenotypes associated with the disease Kearns-Sayre syndrome (ORPHA:480):
- Pigmentary retinopathy (HP:0000580): An abnormality of the retina characterized by pigment deposition. It is typically associated with migration and proliferation of macrophages or retinal pigment epithelial cells into the retina; melanin from these cells causes the pigmentary changes. Pigmentary retinopathy is a common final pathway of many retinal conditions and is often associated with visual loss. Evidence: TAS. Frequency: Very frequent (HP:0040281). (ORPHA:480)
- Progressive external ophthalmoplegia (HP:0000590): Initial bilateral ptosis followed by limitation of eye movements in all directions and slowing of saccades. Evidence: TAS. Frequency: Very frequent (HP:0040281). (ORPHA:480)
- Third degree atrioventricular block (HP:0001709): Third-degree atrioventricular (AV) block (also referred to as complete heart block) is the complete dissociation of the atria and the ventricles. Third-degree AV block exists when more P waves than QRS complexes exist and no relationship (no conduction) exists between them. Evidence: TAS. Frequency: Very frequent (HP:0040281). (ORPHA:480)
- Hearing impairment (HP:0000365): A decreased magnitude of the sensory perception of sound. Evidence: TAS. Frequency: Frequent (HP:0040282). (ORPHA:480)
- Ptosis (HP:0000508): The upper eyelid margin is positioned 3 mm or more lower than usual and covers the superior portion of the iris (objective); or, the upper lid margin obscures at least part of the pupil (subjective). Evidence: TAS. Frequency: Frequent (HP:0040282). (ORPHA:480)
- Anterior hypopituitarism (HP:0000830): A condition of reduced function of the anterior pituitary gland characterized by decreased secretion of one or more of the pituitary hormones growth hormone, thyroid-stimulating hormone, adrenocorticotropic hormone, prolactin, luteinizing hormone, and follicle-stimulating hormone. Evidence: TAS. Frequency: Frequent (HP:0040282). (ORPHA:480)
- Ataxia (HP:0001251): Ataxia refers to impaired coordination of voluntary muscle movement. Cerebellar ataxia refers to ataxia due to dysfunction of the cerebellum. This causes a variety of elementary neurological deficits including asynergy (lack of coordination between muscles, limbs and joints), dysmetria (lack of ability to judge distances that can lead to under- or overshoot in grasping movements), and dysdiadochokinesia (inability to perform rapid movements requiring antagonizing muscle groups to be switched on and off repeatedly). Evidence: TAS. Frequency: Frequent (HP:0040282). (ORPHA:480)
- Hypotonia (HP:0001252): Hypotonia is an abnormally low muscle tone (the amount of tension or resistance to movement in a muscle). Even when relaxed, muscles have a continuous and passive partial contraction which provides some resistance to passive stretching. Hypotonia thus manifests as diminished resistance to passive stretching. Hypotonia is not the same as muscle weakness, although the two conditions can co-exist. Evidence: TAS. Frequency: Frequent (HP:0040282). (ORPHA:480)
- Diminished deep tendon reflex (HP:0001315): A reduction (hyporeflexia) or complete absence (areflexia) of the involuntary muscle contraction normally elicited by a reflex stimulus, such as tapping a deep tendon. Evidence: TAS. Frequency: Frequent (HP:0040282). (ORPHA:480)
- Increased CSF protein concentration (HP:0002922): Increased concentration of protein in the cerebrospinal fluid. Evidence: TAS. Frequency: Frequent (HP:0040282). (ORPHA:480)
- Ragged-red muscle fibers (HP:0003200): An abnormal appearance of muscle fibers observed on muscle biopsy. Ragged red fibers can be visualized with Gomori trichrome staining as irregular and intensely red subsarcolemmal zones, whereas the normal myofibrils are green. The margins of affect fibers appear red and ragged. The ragged-red is due to the accumulation of abnormal mitochondria below the plasma membrane of the muscle fiber, leading to the appearance of a red rim and speckled sarcoplasm. Evidence: TAS. Frequency: Frequent (HP:0040282). (ORPHA:480)
- Skeletal muscle atrophy (HP:0003202): The presence of skeletal muscular atrophy (which is also known as amyotrophy). Evidence: TAS. Frequency: Frequent (HP:0040282). (ORPHA:480)
- EMG abnormality (HP:0003457): Abnormal results of investigations using electromyography (EMG). Evidence: TAS. Frequency: Frequent (HP:0040282). (ORPHA:480)
- Progressive intervertebral space narrowing (HP:0004622): A progressive form of decreased height of the intervertebral disk. Evidence: TAS. Frequency: Frequent (HP:0040282). (ORPHA:480)
- Neck muscle weakness (HP:0000467): Decreased strength of the neck musculature. Evidence: TAS. Frequency: Occasional (HP:0040283). (ORPHA:480)
- Dementia (HP:0000726): A loss of global cognitive ability of sufficient amount to interfere with normal social or occupational function. Dementia represents a loss of previously present cognitive abilities, generally in adults, and can affect memory, thinking, language, judgment, and behavior. Evidence: TAS. Frequency: Occasional (HP:0040283). (ORPHA:480)
- Diabetes mellitus (HP:0000819): A group of abnormalities characterized by hyperglycemia and glucose intolerance. Evidence: TAS. Frequency: Occasional (HP:0040283). (ORPHA:480)
- Delayed puberty (HP:0000823): Passing the age when puberty normally occurs with no physical or hormonal signs of the onset of puberty. Evidence: TAS. Frequency: Occasional (HP:0040283). (ORPHA:480)
- Hypoparathyroidism (HP:0000829): A condition caused by a deficiency of parathyroid hormone characterized by hypocalcemia and hyperphosphatemia. Evidence: TAS. Frequency: Occasional (HP:0040283). (ORPHA:480)
- Muscle weakness (HP:0001324): Reduced strength of muscles. Evidence: TAS. Frequency: Occasional (HP:0040283). (ORPHA:480)
- Tremor (HP:0001337): An unintentional, oscillating to-and-fro muscle movement about a joint axis. Evidence: TAS. Frequency: Occasional (HP:0040283). (ORPHA:480)
- Cardiomyopathy (HP:0001638): A myocardial disorder in which the heart muscle is structurally and functionally abnormal, in the absence of coronary artery disease, hypertension, valvular disease and congenital heart disease sufficient to cause the observed myocardial abnormality. Evidence: TAS. Frequency: Occasional (HP:0040283). (ORPHA:480)
- Renal tubular acidosis (HP:0001947): Acidosis owing to malfunction of the kidney tubules with accumulation of metabolic acids and hyperchloremia, potentially leading to complications including hypokalemia, hypercalcinuria, nephrolithiasis and nephrocalcinosis. Evidence: TAS. Frequency: Occasional (HP:0040283). (ORPHA:480)
- Dysphagia (HP:0002015): Difficulty in swallowing. Evidence: TAS. Frequency: Occasional (HP:0040283). (ORPHA:480)
- Delayed skeletal maturation (HP:0002750): A decreased rate of skeletal maturation. Delayed skeletal maturation can be diagnosed on the basis of an estimation of the bone age from radiographs of specific bones in the human body. Evidence: TAS. Frequency: Occasional (HP:0040283). (ORPHA:480)
- Exercise intolerance (HP:0003546): A functional motor deficit where individuals whose responses to the challenges of exercise fail to achieve levels considered normal for their age and gender. Evidence: TAS. Frequency: Occasional (HP:0040283). (ORPHA:480)
- Short stature (HP:0004322): A height below that which is expected according to age and gender norms. Although there is no universally accepted definition of short stature, many refer to "short stature" as height more than 2 standard deviations below the mean for age and gender (or below the 3rd percentile for age and gender dependent norms). Evidence: TAS. Frequency: Occasional (HP:0040283). (ORPHA:480)
- Hemiplegia/hemiparesis (HP:0004374): Loss of strength in the arm, leg, and sometimes face on one side of the body. Hemiplegia refers to a severe or complete loss of strength, whereas hemiparesis refers to a relatively mild loss of strength. Evidence: TAS. Frequency: Occasional (HP:0040283). (ORPHA:480)
- Chronic kidney disease (HP:0012622): Functional anomaly of the kidney persisting for at least three months. Evidence: TAS. Frequency: Occasional (HP:0040283). (ORPHA:480)
- Cognitive impairment (HP:0100543): Abnormal cognition is characterized by deficits in thinking, reasoning, or remembering. Evidence: TAS. Frequency: Occasional (HP:0040283). (ORPHA:480)